- Bilateral tonic-clonic seizure (HP:0002069): A bilateral tonic-clonic seizure is a seizure defined by a tonic (bilateral increased tone, lasting seconds to minutes) and then a clonic (bilateral sustained rhythmic jerking) phase. Evidence: PCS. Frequency: 1/1. (PMID:20685856)
- Hypogonadotropic hypogonadism (HP:0000044): Hypogonadotropic hypogonadism is characterized by reduced function of the gonads (testes in males or ovaries in females) and results from the absence of the gonadal stimulating pituitary hormones: follicle stimulating hormone (FSH) and luteinizing hormone (LH). Evidence: PCS. Frequency: 1/1. (PMID:20685856)
- Short stature (HP:0004322): A height below that which is expected according to age and gender norms. Although there is no universally accepted definition of short stature, many refer to "short stature" as height more than 2 standard deviations below the mean for age and gender (or below the 3rd percentile for age and gender dependent norms). Evidence: PCS. Frequency: 3/3. (PMID:20685856)
- Seizure (HP:0001250): A seizure is an intermittent abnormality of nervous system physiology characterized by a transient occurrence of signs and/or symptoms due to abnormal excessive or synchronous neuronal activity in the brain. Evidence: PCS. Frequency: 2/2. (PMID:20685856;PMID:41488893)
- Cleft lip (HP:0410030): A gap in the lip or lips. Evidence: PCS. Frequency: 1/3. (PMID:20685856)
- Unilateral cryptorchidism (HP:0012741): Absence of a testis from the scrotum on one side owing to failure of the testis or testes to descend through the inguinal canal to the scrotum. Evidence: PCS. Frequency: 1/1. (PMID:20685856)
- Interictal epileptiform activity (HP:0011182): Epileptiform activity refers to distinctive EEG waves or complexes distinguished from background activity found in in a proportion of human subjects with epilepsy, but which can also be found in subjects without seizures. Interictal epileptiform activity refers to such activity that occurs in the absence of a clinical or subclinical seizure. Evidence: PCS. Frequency: 1/1. (PMID:41488893)
- Childhood onset (HP:0011463): Onset of disease at the age of between 1 and 5 years. Evidence: PCS. Frequency: 1/3. (PMID:20685856)
- Typified by incomplete penetrance (HP:0003829): Description of conditions in which not all individuals with a given genotype exhibit the disease. Penetrance is the proportion that develop disease given a lifespan of 80 years. Evidence: TAS. (OMIM:615849)
- Postnatal growth retardation (HP:0008897): Slow or limited growth after birth. Evidence: PCS. Frequency: 2/2. (PMID:20685856)
- Diabetes insipidus (HP:0000873): A state of excessive water intake and hypotonic (dilute) polyuria. Diabetes insipidus may be due to failure of vasopressin (AVP) release (central or neurogenic diabetes insipidus) or to a failure of the kidney to respond to AVP (nephrogenic diabetes insipidus). Evidence: PCS. Frequency: 1/3. (PMID:20685856)
- Neonatal onset (HP:0003623): Onset of signs or symptoms of disease within the first 28 days of life. Evidence: PCS. Frequency: 2/4. (PMID:20685856;PMID:41488893)
- Cleft palate (HP:0000175): Cleft palate is a developmental defect of the palate resulting from a failure of fusion of the palatine processes and manifesting as a separation of the roof of the mouth (soft and hard palate). Evidence: PCS. Frequency: 1/3. (PMID:20685856)
- Micropenis (HP:0000054): Abnormally small penis. At birth, the normal penis is about 3 cm (stretched length from pubic tubercle to tip of penis) with micropenis less than 2.0-2.5 cm. Evidence: TAS. (OMIM:615849)
- Recurrent urinary tract infections (HP:0000010): Repeated infections of the urinary tract. Evidence: PCS. Frequency: 1/1. (PMID:20685856)
- Delayed skeletal maturation (HP:0002750): A decreased rate of skeletal maturation. Delayed skeletal maturation can be diagnosed on the basis of an estimation of the bone age from radiographs of specific bones in the human body. Evidence: PCS. Frequency: 1/1. (PMID:20685856)
- Decreased circulating luteinizing hormone level (HP:0030344): A reduction in the circulating level of luteinizing hormone (LH). Evidence: PCS. Frequency: 1/3. (PMID:20685856)
- Global developmental delay (HP:0001263): A delay in the achievement of motor or mental milestones in the domains of development of a child, including motor skills, speech and language, cognitive skills, and social and emotional skills. This term should only be used to describe children younger than five years of age. Evidence: PCS. Frequency: 1/1. (PMID:41488893)
- Decreased circulating follicle stimulating hormone concentration (HP:0030341): A reduction of the circulating level of follicle-stimulating hormone (FSH). Evidence: PCS. Frequency: 1/3. (PMID:20685856)
- Midface retrusion (HP:0011800): Posterior positions and/or vertical shortening of the infraorbital and perialar regions, or increased concavity of the face and/or reduced nasolabial angle. Evidence: TAS. Frequency: Occasional (HP:0040283). (OMIM:615849)
- Hypopituitarism (HP:0040075). Evidence: TAS. (OMIM:615849)
- Decreased growth hormone responses to growth hormone-releasing hormone challenge (HP:0033579): Insufficient growth hormone secretion following administration of growth hormone-releasing hormone. Evidence: PCS. Frequency: 1/1. (PMID:20685856)
- Postaxial polydactyly (HP:0100259): A form of polydactyly in which the extra digit or digits are localized on the side of the fifth finger or fifth toe. Evidence: PCS. Frequency: 0/2. (PMID:20685856)
- Decreased circulating cortisol level (HP:0008163): Abnormally reduced concentration of cortisol in the blood. Evidence: PCS. Frequency: 1/1. (PMID:20685856)
- Hyperbilirubinemia (HP:0002904): An increased amount of bilirubin in the blood. Evidence: PCS. Frequency: 1/1. (PMID:41488893)
- Reduced circulating prolactin concentration (HP:0008202): A reduced level of prolactin in the blood circulation. Prolactin is a protein hormone that is secreted by lactotrophs in the anterior pituitary and that stimulates mammary gland development and milk production. Evidence: PCS. Frequency: 1/3. (PMID:20685856)
- Hypotelorism (HP:0000601): Interpupillary distance less than 2 SD below the mean (alternatively, the appearance of an decreased interpupillary distance or closely spaced eyes). Evidence: TAS. Frequency: Occasional (HP:0040283). (OMIM:615849)
- Cyanosis (HP:0000961): Bluish discoloration of the skin and mucosa due to poor circulation or inadequate oxygenation of arterial or capillary blood. Evidence: PCS. Frequency: 0/1. (PMID:41488893)
- Autosomal dominant inheritance (HP:0000006): A mode of inheritance that is observed for traits related to a gene encoded on one of the autosomes (i.e., the human chromosomes 1-22) in which a trait manifests in heterozygotes. In the context of medical genetics, an autosomal dominant disorder is caused when a single copy of the mutant allele is present. Males and females are affected equally, and can both transmit the disorder with a risk of 50% for each child of inheriting the mutant allele. Evidence: PCS. (PMID:20685856)
- Cleft upper lip (HP:0000204): A gap or groove in the upper lip. This is a congenital defect resulting from nonfusion of tissues of the lip during embryonal development. Evidence: TAS. Frequency: Occasional (HP:0040283). (OMIM:615849)
- Respiratory failure requiring assisted ventilation (HP:0004887): A state of respiratory distress that requires a life saving intervention in the form of gaining airway access and instituting positive pressure ventilation. Evidence: PCS. Frequency: 1/1. (PMID:41488893)
- Hypertonia (HP:0001276): A condition in which there is increased muscle tone so that arms or legs, for example, are stiff and difficult to move. Evidence: PCS. Frequency: 1/1. (PMID:41488893)
- Congenital onset (HP:0003577): A phenotypic abnormality that is present at birth. Evidence: PCS. Frequency: 1/3. (PMID:20685856)
- Anterior pituitary hypoplasia (HP:0010627): Underdevelopment of the anterior pituitary gland. Evidence: PCS. Frequency: 3/3. (PMID:20685856)
- Decreased circulating insulin-like growth factor 1 concentration (HP:0030353): The concentration of insulin-like growth factor 1 (IGF1) in the blood circulation is below the lower limit of normal. Evidence: PCS. Frequency: 2/2. (PMID:20685856)
- Ectopic posterior pituitary (HP:0011755): An abnormal anatomical location of the posterior lobe of the hypophysis, also known as the neurohypophysis. The posterior pituitary is normally present in the dorsal portion of the sella turcica, but when ectopic is usually near the median eminence. This defect is likely to be due to abnormal migration during embryogenesis. Evidence: PCS. Frequency: 2/3. (PMID:20685856)
- Decreased circulating free T4 concentration (HP:0033078): A reduced concentration of free thyroxine (fT4) in the blood circulation. Evidence: PCS. Frequency: 1/1. (PMID:20685856)
- Decreased thyroid-stimulating hormone level (HP:0031098): Reduced amount of the thyroid-stimulating hormone (TSH), which is produced by the anterior pituitary gland and stimulates the function of the thyroid gland. Evidence: PCS. Frequency: 2/3. (PMID:20685856)
- Hypoglycemia (HP:0001943): A decreased concentration of glucose in the blood. Evidence: PCS. Frequency: 2/2. (PMID:20685856)
- Bilateral postaxial polydactyly (HP:0006136). Evidence: PCS. Frequency: 1/1. (PMID:20685856)
- Abnormally high-pitched voice (HP:0001620): A persistent (minutes to hours) abnormal increase in the pitch (frequency) of the voice for the context or social situation or significantly different from baseline of the individual. Evidence: PCS. Frequency: 1/1. (PMID:20685856)
- Prolonged neonatal jaundice (HP:0006579): Neonatal jaundice refers to a yellowing of the skin and other tissues of a newborn infant as a result of increased concentrations of bilirubin in the blood. Neonatal jaundice affects over half of all newborns to some extent in the first week of life. Prolonged neonatal jaundice is said to be present if the jaundice persists for longer than 14 days in term infants and 21 days in preterm infants. Evidence: PCS. Frequency: 1/1. (PMID:41488893)
- Vesicoureteral reflux (HP:0000076): Abnormal (retrograde) movement of urine from the bladder into ureters or kidneys related to inadequacy of the valvular mechanism at the ureterovesicular junction or other causes. Evidence: PCS. Frequency: 1/1. (PMID:20685856)
- Adrenocorticotropic hormone deficiency (HP:0011748): A reduced ability to secrete adrenocorticotropic hormone (ACTH), a hormone that stimulates the adrenal cortex to secrete of glucocorticoids such as cortisol. Evidence: PCS. Frequency: 3/3. (PMID:20685856)
- Holoprosencephaly (HP:0001360): Holoprosencephaly is a structural anomaly of the brain in which the developing forebrain fails to divide into two separate hemispheres and ventricles. Evidence: PCS. Frequency: 0/3. (PMID:20685856)
- Postaxial hand polydactyly (HP:0001162): Supernumerary digits located at the ulnar side of the hand (that is, on the side with the fifth finger). Evidence: PCS. Frequency: 1/1. (PMID:41488893)
- Reduced circulating growth hormone concentration (HP:0034323): Concentration of growth hormone in the blood circulation below normal limits. Evidence: PCS. Frequency: 3/3. (PMID:20685856)
- Severe global developmental delay (HP:0011344): A severe delay in the achievement of motor or mental milestones in the domains of development of a child. Evidence: PCS. Frequency: 2/2. (PMID:20685856)
- Depressed nasal bridge (HP:0005280): Posterior positioning of the nasal root in relation to the overall facial profile for age. Evidence: PCS. Frequency: 1/1. (PMID:20685856)
- Central hypothyroidism (HP:0011787): A type of hypothyroidism due to an insufficient stimulation of an otherwise normal thyroid gland. Central hypothyroidism is caused by either pituitary (secondary hypothyroidism) or hypothalamic (tertiary hypothyroidism) defects. Evidence: PCS. Frequency: 1/1. (PMID:20685856)
- Nasogastric tube feeding (HP:0040288): The condition of inability to eat normally treated by placement of a thin tube through the nose into the stomach that is then used to carry food. Evidence: PCS. Frequency: 1/1. (PMID:41488893)
- Decreased response to growth hormone stimulation test (HP:0000824): Insufficient responses to growth hormone (GH) provocation tests. GH deficiency is defined as a serum peak GH concentration less than 10 ng/mL on provocation with a combination of at least two separate stimulation tests. Evidence: PCS. Frequency: 1/1. (PMID:20685856)
- Postaxial foot polydactyly (HP:0001830): Polydactyly of the foot most commonly refers to the presence of six toes on one foot. Postaxial polydactyly affects the lateral ray and the duplication may range from a well-formed articulated digit to a rudimentary digit. Evidence: PCS. Frequency: 1/1. (PMID:41488893)
- Abnormal TSH response to thyrotrophin-releasing hormone stimulation test (HP:0033080): Thyrotrophin-releasing hormone (TRH) is a hypothalamic tripeptide synthesized by, stored within, and released from the hypothalamus. It stimulates the synthesis and release of thyroid-stimulating hormone (TSH) from the anterior pituitary gland. Following administration of exogenous TRH, a transient increase in serum TSH is expected. This term refers to an abnormal response in the TRH stimulation test. Evidence: PCS. Frequency: 1/1. (PMID:20685856)
- Cryptorchidism (HP:0000028): Testis in inguinal canal. That is, absence of one or both testes from the scrotum owing to failure of the testis or testes to descend through the inguinal canal to the scrotum. Evidence: TAS. (OMIM:615849)
These phenotypes are associated with the disease postaxial polydactyly-anterior pituitary anomalies-facial dysmorphism syndrome (OMIM:615849).